- Sensorineural hearing impairment (HP:0000407): A type of hearing impairment in one or both ears related to an abnormal functionality of the cochlear nerve. Evidence: TAS. Frequency: Very frequent (HP:0040281). (ORPHA:300179)
- Hyperextensible skin (HP:0000974): A condition in which the skin can be stretched beyond normal, and then returns to its initial position. Evidence: TAS. Frequency: Very frequent (HP:0040281). (ORPHA:300179)
- Motor delay (HP:0001270): A type of Developmental delay characterized by a delay in acquiring motor skills. Evidence: TAS. Frequency: Very frequent (HP:0040281). (ORPHA:300179)
- Joint hypermobility (HP:0001382): The capability that a joint (or a group of joints) has to move, passively and/or actively, beyond normal limits along physiological axes. Evidence: TAS. Frequency: Very frequent (HP:0040281). (ORPHA:300179)
- Pes planus (HP:0001763): A foot where the longitudinal arch of the foot is in contact with the ground or floor when the individual is standing; or, in a patient lying supine, a foot where the arch is in contact with the surface of a flat board pressed against the sole of the foot by the examiner with a pressure similar to that expected from weight bearing; or, the height of the arch is reduced. Evidence: TAS. Frequency: Very frequent (HP:0040281). (ORPHA:300179)
- Poor head control (HP:0002421): Difficulty to maintain correct position of the head while standing or sitting. Infant head lag is observed when the head seems to flop around or lags posteriorly behind the trunk. Several articles have maintained that head lag should be absent by age 3 to 4 months. Evidence: TAS. Frequency: Very frequent (HP:0040281). (ORPHA:300179)
- Kyphoscoliosis (HP:0002751): An abnormal curvature of the spine in both a coronal (lateral) and sagittal (back-to-front) plane. Evidence: TAS. Frequency: Very frequent (HP:0040281). (ORPHA:300179)
- Myopathy (HP:0003198): A disorder of muscle unrelated to impairment of innervation or neuromuscular junction. Evidence: TAS. Frequency: Very frequent (HP:0040281). (ORPHA:300179)
- Skeletal muscle atrophy (HP:0003202): The presence of skeletal muscular atrophy (which is also known as amyotrophy). Evidence: TAS. Frequency: Very frequent (HP:0040281). (ORPHA:300179)
- Severe muscular hypotonia (HP:0006829): A severe degree of muscular hypotonia characterized by markedly reduced muscle tone. Evidence: TAS. Frequency: Very frequent (HP:0040281). (ORPHA:300179)
- Follicular hyperkeratosis (HP:0007502): A skin condition characterized by excessive development of keratin in hair follicles, resulting in rough, cone-shaped, elevated papules resulting from closure of hair follicles with a white plug of sebum. Evidence: TAS. Frequency: Very frequent (HP:0040281). (ORPHA:300179)
- Myopia (HP:0000545): An abnormality of refraction characterized by the ability to see objects nearby clearly, while objects in the distance appear blurry. Evidence: TAS. Frequency: Frequent (HP:0040282). (ORPHA:300179)
- Osteopenia (HP:0000938): Osteopenia is a term to define bone density that is not normal but also not as low as osteoporosis. By definition from the World Health Organization osteopenia is defined by bone densitometry as a T score -1 to -2.5. Evidence: TAS. Frequency: Frequent (HP:0040282). (ORPHA:300179)
- Bruising susceptibility (HP:0000978): An ecchymosis (bruise) refers to the skin discoloration caused by the escape of blood into the tissues from ruptured blood vessels. This term refers to an abnormally increased susceptibility to bruising. The corresponding phenotypic abnormality is generally elicited on medical history as a report of frequent ecchymoses or bruising without adequate trauma. Evidence: TAS. Frequency: Frequent (HP:0040282). (ORPHA:300179)
- Atrophic scars (HP:0001075): Scars that form a depression compared to the level of the surrounding skin because of damage to the collagen, fat or other tissues below the skin. Evidence: TAS. Frequency: Frequent (HP:0040282). (ORPHA:300179)
- Muscle weakness (HP:0001324): Reduced strength of muscles. Evidence: TAS. Frequency: Frequent (HP:0040282). (ORPHA:300179)
- Elevated circulating creatine kinase activity (HP:0003236): The activity of creatine kinase in the blood circulation is above the upper limit of normal. Evidence: TAS. Frequency: Frequent (HP:0040282). (ORPHA:300179)
- Easy fatigability (HP:0003388): Increased susceptibility to fatigue. Evidence: TAS. Frequency: Frequent (HP:0040282). (ORPHA:300179)
- Hernia (HP:0100790). Evidence: TAS. Frequency: Frequent (HP:0040282). (ORPHA:300179)
- Abnormal eye morphology (HP:0012372): A structural anomaly of the globe of the eye, or bulbus oculi. Evidence: TAS. Frequency: Occasional (HP:0040283). (ORPHA:300179)
- Arterial rupture (HP:0025019): Sudden breakage of an artery leading to leakage of blood from the circulation. Evidence: TAS. Frequency: Occasional (HP:0040283). (ORPHA:300179)
- Microcornea (HP:0000482): A congenital abnormality of the cornea in which the cornea and the anterior segment of the eye are smaller than normal. The horizontal diameter of the cornea does not reach 10 mm even in adulthood. Evidence: TAS. Frequency: Very rare (HP:0040284). (ORPHA:300179)
- Disproportionate tall stature (HP:0001519): A tall and slim body build with increased arm span to height ratio (>1.05) and a reduced upper-to-lower segment ratio (<0.85), i.e., unusually long arms and legs. The extremities as well as the hands and feet are unusually slim. Evidence: TAS. Frequency: Very rare (HP:0040284). (ORPHA:300179)
These phenotypes are associated with the disease Kyphoscoliotic Ehlers-Danlos syndrome due to FKBP22 deficiency (ORPHA:300179).